- Abnormal vestibular function (HP:0001751): An abnormality of the functioning of the vestibular apparatus. Evidence: PCS. Frequency: 0/3. (PMID:33496845)
- Sensorineural hearing impairment (HP:0000407): A type of hearing impairment in one or both ears related to an abnormal functionality of the cochlear nerve. Evidence: PCS. Frequency: 3/3. Onset: Childhood onset (HP:0011463). (PMID:33496845)
- Childhood onset (HP:0011463): Onset of disease at the age of between 1 and 5 years. Evidence: PCS. Frequency: 3/3. (PMID:33496845)
- Autosomal recessive inheritance (HP:0000007): A mode of inheritance that is observed for traits related to a gene encoded on one of the autosomes (i.e., the human chromosomes 1-22) in which a trait manifests in individuals with two pathogenic alleles, either homozygotes (two copies of the same mutant allele) or compound heterozygotes (whereby each copy of a gene has a distinct mutant allele). Evidence: PCS. (PMID:33496845)
These phenotypes are associated with the disease hearing loss, autosomal recessive 117 (OMIM:619174).